- Nuclear cataract (HP:0100018): A nuclear cataract is an opacity or clouding that develops in the lens nucleus. That is, a nuclear cataract is one that is located in the center of the lens. The nucleus tends to darken changing from clear to yellow and sometimes brown. Evidence: TAS. Onset: Congenital onset (HP:0003577). (OMIM:611544)
- Congenital onset (HP:0003577): A phenotypic abnormality that is present at birth. Evidence: PCS. Frequency: 8/8. (PMID:12360425)
- Nystagmus (HP:0000639): Rhythmic, involuntary oscillations of one or both eyes related to abnormality in fixation, conjugate gaze, or vestibular mechanisms. Evidence: TAS. (OMIM:611544)
- Pulverulent cataract (HP:0010693): A kind of congenital cataract that is characterized by a hollow sphere of punctate opacities involving the fetal nucleus and that usually occurs bilaterally. Evidence: PCS. Frequency: 8/8. (PMID:12360425)
- Microcornea (HP:0000482): A congenital abnormality of the cornea in which the cornea and the anterior segment of the eye are smaller than normal. The horizontal diameter of the cornea does not reach 10 mm even in adulthood. Evidence: TAS. Frequency: Occasional (HP:0040283). (OMIM:611544)
- Developmental cataract (HP:0000519): A cataract that occurs congenitally as the result of a developmental defect, in contrast to the majority of cataracts that occur in adulthood as the result of degenerative changes of the lens. Evidence: IEA. (OMIM:611544)
- Amblyopia (HP:0000646): Reduced visual acuity that is uncorrectable by lenses in the absence of detectable anatomic defects in the eye or visual pathways. Evidence: TAS. Frequency: Occasional (HP:0040283). (OMIM:611544)
- Autosomal recessive inheritance (HP:0000007): A mode of inheritance that is observed for traits related to a gene encoded on one of the autosomes (i.e., the human chromosomes 1-22) in which a trait manifests in individuals with two pathogenic alleles, either homozygotes (two copies of the same mutant allele) or compound heterozygotes (whereby each copy of a gene has a distinct mutant allele). Evidence: TAS. (OMIM:611544)
- Reduced visual acuity (HP:0007663). Evidence: TAS. (OMIM:611544)
- Autosomal dominant inheritance (HP:0000006): A mode of inheritance that is observed for traits related to a gene encoded on one of the autosomes (i.e., the human chromosomes 1-22) in which a trait manifests in heterozygotes. In the context of medical genetics, an autosomal dominant disorder is caused when a single copy of the mutant allele is present. Males and females are affected equally, and can both transmit the disorder with a risk of 50% for each child of inheriting the mutant allele. Evidence: PCS. (PMID:12360425)
These phenotypes are associated with the disease cataract 17 multiple types (OMIM:611544).